Phenotypes associated with the disease Postorgasmic illness syndrome (ORPHA:279947):
- Abnormality of mental function (HP:0011446): Cognitive, psychiatric, or memory anomaly. Evidence: TAS. Frequency: Very frequent (HP:0040281). (ORPHA:279947)
- Fatigue (HP:0012378): A subjective feeling of tiredness characterized by a lack of energy and motivation. Evidence: TAS. Frequency: Very frequent (HP:0040281). (ORPHA:279947)
- Abnormality of the nose (HP:0000366): An abnormality of the nose. Evidence: TAS. Frequency: Frequent (HP:0040282). (ORPHA:279947)
- Irritability (HP:0000737): An emotional state characterized by negative feelings of heightened frustration, annoyance, or feeling upset, often triggered by internal factors (e.g., fatigue, hunger, unfulfilled desires) or external factors (e.g., social or environmental challenges). Irritability may be unpredictable, and is accompanied by a lowered threshold for emotional reactivity and observable features (speech, facial expressions, or psychomotor activity). Evidence: TAS. Frequency: Frequent (HP:0040282). (ORPHA:279947)
- Hypertension (HP:0000822): The presence of chronic increased pressure in the systemic arterial system. Evidence: TAS. Frequency: Frequent (HP:0040282). (ORPHA:279947)
- Hyperhidrosis (HP:0000975): Abnormal excessive perspiration (sweating) despite the lack of appropriate stimuli like hot and humid weather. Evidence: TAS. Frequency: Frequent (HP:0040282). (ORPHA:279947)
- Fever (HP:0001945): Body temperature elevated above the normal range. Evidence: TAS. Frequency: Frequent (HP:0040282). (ORPHA:279947)
- Headache (HP:0002315): Cephalgia, or pain sensed in various parts of the head, not confined to the area of distribution of any nerve. Evidence: TAS. Frequency: Frequent (HP:0040282). (ORPHA:279947)
- Xerostomia (HP:0000217): Dryness of the mouth due to salivary gland dysfunction. Evidence: TAS. Frequency: Occasional (HP:0040283). (ORPHA:279947)
- Photophobia (HP:0000613): Excessive sensitivity to light with the sensation of discomfort or pain in the eyes due to exposure to bright light. Evidence: TAS. Frequency: Occasional (HP:0040283). (ORPHA:279947)
- Blurred vision (HP:0000622): Lack of sharpness of vision resulting in the inability to see fine detail. Evidence: TAS. Frequency: Occasional (HP:0040283). (ORPHA:279947)
- Depression (HP:0000716): Frequently experiencing feelings of being down, miserable, and/or hopeless; struggling to recover from these moods; having a pessimistic outlook on the future; feeling a pervasive sense of shame; having a low self-worth; experiencing thoughts of suicide and engaging in suicidal behavior. Evidence: TAS. Frequency: Occasional (HP:0040283). (ORPHA:279947)
- Delayed speech and language development (HP:0000750): A degree of language development that is significantly below the norm for a child of a specified age. Evidence: TAS. Frequency: Occasional (HP:0040283). (ORPHA:279947)
- Dysarthria (HP:0001260): Dysarthric speech is a general description referring to a neurological speech disorder characterized by poor articulation. Depending on the involved neurological structures, dysarthria may be further classified as spastic, flaccid, ataxic, hyperkinetic and hypokinetic, or mixed. Evidence: TAS. Frequency: Occasional (HP:0040283). (ORPHA:279947)
- Muscle weakness (HP:0001324): Reduced strength of muscles. Evidence: TAS. Frequency: Occasional (HP:0040283). (ORPHA:279947)
- Hoarse voice (HP:0001609): Hoarseness refers to a change in the pitch or quality of the voice, with the voice sounding weak, very breathy, scratchy, or husky. Evidence: TAS. Frequency: Occasional (HP:0040283). (ORPHA:279947)
- Palpitations (HP:0001962): A sensation that the heart is pounding or racing, which is a non-specific sign but may be a manifestation of arrhythmia. Evidence: TAS. Frequency: Occasional (HP:0040283). (ORPHA:279947)
- Muscle stiffness (HP:0003552): A condition in which muscles cannot be moved quickly without accompanying pain or spasm. Evidence: TAS. Frequency: Occasional (HP:0040283). (ORPHA:279947)